- Torticollis (HP:0000473): Involuntary contractions of the neck musculature resulting in an abnormal posture of or abnormal movements of the head. Evidence: PCS. Frequency: 5/8. (PMID:25983243)
- Progressive (HP:0003676): Applies to a disease manifestation that increases in scope or severity over the course of time, i.e., that worsens with age. Evidence: PCS. (PMID:25983243)
- Juvenile onset (HP:0003621): Onset of signs or symptoms of disease between the age of 5 and 15 years. Evidence: PCS. Frequency: 5/8. (PMID:25983243)
- Dystonia (HP:0001332): An abnormally increased muscular tone that causes fixed abnormal postures. There is a slow, intermittent twisting motion that leads to exaggerated turning and posture of the extremities and trunk. Evidence: PCS. Frequency: 7/8. (PMID:25983243)
- Dysarthria (HP:0001260): Dysarthric speech is a general description referring to a neurological speech disorder characterized by poor articulation. Depending on the involved neurological structures, dysarthria may be further classified as spastic, flaccid, ataxic, hyperkinetic and hypokinetic, or mixed. Evidence: PCS. Frequency: 1/8. (PMID:25983243)
- Laryngeal dystonia (HP:0012049): A form of focal dystonia that affects the vocal cords, associated with involuntary contractions of the vocal cords causing interruptions of speech and affecting the voice quality and often leading to patterned, repeated breaks in speech. Evidence: PCS. (PMID:25983243)
- Early young adult onset (HP:0025708): Onset of disease at an age of greater than or equal to 16 to under 19 years. Evidence: PCS. Frequency: 1/8. (PMID:25983243)
- Dysphonia (HP:0001618): Difficulty in speaking due to a physical disorder of the mouth, tongue, throat, or vocal cords. Associated with a known physical or neurological cause. Evidence: PCS. (PMID:25983243)
- Depression (HP:0000716): Frequently experiencing feelings of being down, miserable, and/or hopeless; struggling to recover from these moods; having a pessimistic outlook on the future; feeling a pervasive sense of shame; having a low self-worth; experiencing thoughts of suicide and engaging in suicidal behavior. Evidence: PCS. Frequency: 1/8. (PMID:25983243)
- Childhood onset (HP:0011463): Onset of disease at the age of between 1 and 5 years. Evidence: PCS. Frequency: 2/8. (PMID:25983243)
- Anxiety (HP:0000739): Intense feelings of nervousness, tension, or panic often arise in response to interpersonal stresses. There is worry about the negative effects of past unpleasant experiences and future negative possibilities. Individuals may feel fearful, apprehensive, or threatened by uncertainty, and they may also have fears of falling apart or losing control. Evidence: PCS. Frequency: 1/8. (PMID:25983243)
- Autosomal dominant inheritance (HP:0000006): A mode of inheritance that is observed for traits related to a gene encoded on one of the autosomes (i.e., the human chromosomes 1-22) in which a trait manifests in heterozygotes. In the context of medical genetics, an autosomal dominant disorder is caused when a single copy of the mutant allele is present. Males and females are affected equally, and can both transmit the disorder with a risk of 50% for each child of inheriting the mutant allele. Evidence: PCS. (PMID:25983243)
- Blepharospasm (HP:0000643): A focal dystonia that affects the muscles of the eyelids and brow, associated with involuntary recurrent spasm of both eyelids. Evidence: PCS. Frequency: 3/8. (PMID:25983243)
- Myoclonus (HP:0001336): Very brief, involuntary random muscular contractions occurring at rest, in response to sensory stimuli, or accompanying voluntary movements. Evidence: PCS. Frequency: 7/8. (PMID:25983243)
These phenotypes are associated with the disease myoclonic dystonia 26 (OMIM:616398).